- Patchy alopecia (HP:0002232): Transient, non-scarring hair loss and preservation of the hair follicle located in in well-defined patches. Evidence: TAS. (OMIM:104110)
- Autosomal dominant inheritance (HP:0000006): A mode of inheritance that is observed for traits related to a gene encoded on one of the autosomes (i.e., the human chromosomes 1-22) in which a trait manifests in heterozygotes. In the context of medical genetics, an autosomal dominant disorder is caused when a single copy of the mutant allele is present. Males and females are affected equally, and can both transmit the disorder with a risk of 50% for each child of inheriting the mutant allele. Evidence: TAS. (OMIM:104110)
These phenotypes are associated with the disease familial focal alopecia (OMIM:104110).